Phenotypes associated with the disease diaphragmatic defect-limb deficiency-skull defect syndrome (OMIM:601163):
- Amelia (HP:0009827): Congenital absence (aplasia) of one or more limbs. Evidence: IEA. (OMIM:601163)
- Toe syndactyly (HP:0001770): Webbing or fusion of the toes, involving soft parts only or including bone structure. Bony fusions are referred to as "bony" Syndactyly if the fusion occurs in a radio-ulnar axis. Fusions of bones of the toes in a proximo-distal axis are referred to as "Symphalangism". Evidence: IEA. (OMIM:601163)
- Pulmonary hypoplasia (HP:0002089). Evidence: IEA. (OMIM:601163)
- Anteverted nares (HP:0000463): Anteriorly-facing nostrils viewed with the head in the Frankfurt horizontal and the eyes of the observer level with the eyes of the subject. This gives the appearance of an upturned nose (upturned nasal tip). Evidence: TAS. (OMIM:601163)
- Decreased skull ossification (HP:0004331): A reduction in the magnitude or amount of ossification of the skull. Evidence: IEA. (OMIM:601163)
- Hypertelorism (HP:0000316): Interpupillary distance more than 2 SD above the mean (alternatively, the appearance of an increased interpupillary distance or widely spaced eyes). Evidence: TAS. (OMIM:601163)
- Testicular atrophy (HP:0000029): Wasting (atrophy) of the testicle (the male gonad) manifested by a decrease in size and potentially by a loss of fertility. Evidence: TAS. (OMIM:601163)
- Autosomal recessive inheritance (HP:0000007): A mode of inheritance that is observed for traits related to a gene encoded on one of the autosomes (i.e., the human chromosomes 1-22) in which a trait manifests in individuals with two pathogenic alleles, either homozygotes (two copies of the same mutant allele) or compound heterozygotes (whereby each copy of a gene has a distinct mutant allele). Evidence: TAS. (OMIM:601163)
- Omphalocele (HP:0001539): A midline anterior incomplete closure of the abdominal wall in which there is herniation of the abdominal viscera into the base of the abdominal cord. Evidence: IEA. (OMIM:601163)
- Clinodactyly of the 5th finger (HP:0004209): Clinodactyly refers to a bending or curvature of the fifth finger in the radial direction (i.e., towards the 4th finger). Evidence: TAS. (OMIM:601163)
- Syndactyly (HP:0001159): Webbing or fusion of the fingers or toes, involving soft parts only or including bone structure. Bony fusions are referred to as "bony" syndactyly if the fusion occurs in a radio-ulnar axis. Fusions of bones of the fingers or toes in a proximo-distal axis are referred to as "symphalangism". Evidence: TAS. (OMIM:601163)
- Intestinal malrotation (HP:0002566): An abnormality of the intestinal rotation and fixation that normally occurs during the development of the gut. This can lead to volvulus, or twisting of the intestine that causes obstruction and necrosis. Evidence: TAS. (OMIM:601163)
- Congenital diaphragmatic hernia (HP:0000776): The presence of a hernia of the diaphragm present at birth. Evidence: TAS. (OMIM:601163)
- Low-set ears (HP:0000369): Upper insertion of the ear to the scalp below an imaginary horizontal line drawn between the inner canthi of the eye and extending posteriorly to the ear. Evidence: TAS. (OMIM:601163)
- Abnormality of the diaphragm (HP:0000775): Any abnormality of the diaphragm, the sheet of skeletal muscle that separates the thoracic cavity from the abdominal cavity. Evidence: IEA. (OMIM:601163)